- Elevated circulating aspartate aminotransferase concentration (HP:0031956): The concentration of aspartate aminotransferase (AST) in the blood circulation is above the upper limit of normal. Evidence: PCS. Frequency: 1/1. (PMID:27647924)
- Delayed speech and language development (HP:0000750): A degree of language development that is significantly below the norm for a child of a specified age. Evidence: PCS. Frequency: 1/1. (PMID:27647924)
- Mild intellectual disability (HP:0001256): Mild intellectual disability (ID) is defined as a type of ID characterized by mildly sub-average adaptive functioning and intellectual functioning, with an intelligence quotient (IQ) the range of 50-69. Evidence: PCS. Frequency: 1/1. (PMID:27647924)
- Dysmetria (HP:0001310): A type of ataxia characterized by the inability to carry out movements with the correct range and motion across the plane of more than one joint related to incorrect estimation of the distances required for targeted movements. Evidence: PCS. Frequency: 1/1. (PMID:27647924)
- Gait ataxia (HP:0002066): A type of ataxia characterized by the impairment of the ability to coordinate the movements required for normal walking. Gait ataxia is characteirzed by a wide-based staggering gait with a tendency to fall. Evidence: PCS. Frequency: 1/1. (PMID:27647924)
- Global developmental delay (HP:0001263): A delay in the achievement of motor or mental milestones in the domains of development of a child, including motor skills, speech and language, cognitive skills, and social and emotional skills. This term should only be used to describe children younger than five years of age. Evidence: PCS. Frequency: 1/1. (PMID:27647924)
- Ataxia (HP:0001251): Ataxia refers to impaired coordination of voluntary muscle movement. Cerebellar ataxia refers to ataxia due to dysfunction of the cerebellum. This causes a variety of elementary neurological deficits including asynergy (lack of coordination between muscles, limbs and joints), dysmetria (lack of ability to judge distances that can lead to under- or overshoot in grasping movements), and dysdiadochokinesia (inability to perform rapid movements requiring antagonizing muscle groups to be switched on and off repeatedly). Evidence: TAS. (OMIM:617308)
- Infantile onset (HP:0003593): Onset of signs or symptoms of disease between 28 days to one year of life. Evidence: PCS. Frequency: 1/1. (PMID:27647924)
- Slurred speech (HP:0001350): Abnormal coordination of muscles involved in speech. Evidence: PCS. Frequency: 1/1. (PMID:27647924)
- Steatorrhea (HP:0002570): Greater than normal amounts of fat in the feces. This is a result of malabsorption of lipids in the small intestine and results in frothy foul-smelling fecal matter that floats. Evidence: PCS. Frequency: 1/1. (PMID:27647924)
- Hypolipidemia (HP:0045014). Evidence: PCS. Frequency: 1/1. (PMID:27647924)
- Elevated circulating alanine aminotransferase concentration (HP:0031964): An abnormally high concentration in the circulation of alanine aminotransferase (ALT). Evidence: PCS. Frequency: 1/1. (PMID:27647924)
- Decreased circulating vitamin D concentration (HP:0100512): The concentration of vitamin D in the blood circulation is below the lower limit of normal. Evidence: PCS. Frequency: 1/1. (PMID:27647924)
- Autosomal recessive inheritance (HP:0000007): A mode of inheritance that is observed for traits related to a gene encoded on one of the autosomes (i.e., the human chromosomes 1-22) in which a trait manifests in individuals with two pathogenic alleles, either homozygotes (two copies of the same mutant allele) or compound heterozygotes (whereby each copy of a gene has a distinct mutant allele). Evidence: PCS. (PMID:27647924)
- Vertical supranuclear gaze palsy (HP:0000511): A supranuclear gaze palsy is an inability to look in a vertical direction as a result of cerebral impairment. There is a loss of the voluntary aspect of eye movements, but, as the brainstem is still intact, all the reflex conjugate eye movements are normal. Evidence: PCS. Frequency: 1/1. (PMID:27647924)
These phenotypes are associated with the disease congenital bile acid synthesis defect 6 (OMIM:617308).